- Triangular face (HP:0000325): Facial contour, as viewed from the front, triangular in shape, with breadth at the temples and tapering to a narrow chin. Evidence: TAS. Frequency: Frequent (HP:0040282). (ORPHA:231144)
- Failure to thrive (HP:0001508): Failure to thrive (FTT) refers to a child whose physical growth is substantially below the norm. Evidence: TAS. Frequency: Frequent (HP:0040282). (ORPHA:231144)
- Intrauterine growth retardation (HP:0001511): An abnormal restriction of fetal growth with fetal weight below the tenth percentile for gestational age. Evidence: TAS. Frequency: Frequent (HP:0040282). (ORPHA:231144)
- Small for gestational age (HP:0001518): Smaller than normal size according to sex and gestational age related norms, defined as a weight below the 10th percentile for the gestational age. Evidence: TAS. Frequency: Frequent (HP:0040282). (ORPHA:231144)
- Oligohydramnios (HP:0001562): Diminished amniotic fluid volume in pregnancy. Evidence: TAS. Frequency: Frequent (HP:0040282). (ORPHA:231144)
- Delayed skeletal maturation (HP:0002750): A decreased rate of skeletal maturation. Delayed skeletal maturation can be diagnosed on the basis of an estimation of the bone age from radiographs of specific bones in the human body. Evidence: TAS. Frequency: Frequent (HP:0040282). (ORPHA:231144)
- Clinodactyly of the 5th finger (HP:0004209): Clinodactyly refers to a bending or curvature of the fifth finger in the radial direction (i.e., towards the 4th finger). Evidence: TAS. Frequency: Frequent (HP:0040282). (ORPHA:231144)
- Short stature (HP:0004322): A height below that which is expected according to age and gender norms. Although there is no universally accepted definition of short stature, many refer to "short stature" as height more than 2 standard deviations below the mean for age and gender (or below the 3rd percentile for age and gender dependent norms). Evidence: TAS. Frequency: Frequent (HP:0040282). (ORPHA:231144)
- Postnatal growth retardation (HP:0008897): Slow or limited growth after birth. Evidence: TAS. Frequency: Frequent (HP:0040282). (ORPHA:231144)
- Facial asymmetry (HP:0000324): An abnormal difference between the left and right sides of the face. Evidence: TAS. Frequency: Occasional (HP:0040283). (ORPHA:231144)
- Motor delay (HP:0001270): A type of Developmental delay characterized by a delay in acquiring motor skills. Evidence: TAS. Frequency: Occasional (HP:0040283). (ORPHA:231144)
- Specific learning disability (HP:0001328): Impairment of certain skills such as reading or writing, coordination, self-control, or attention that interfere with the ability to learn. The impairment is not related to a global deficiency of intelligence. Evidence: TAS. Frequency: Occasional (HP:0040283). (ORPHA:231144)
- Umbilical hernia (HP:0001537): Protrusion of abdominal contents through a defect in the abdominal wall musculature around the umbilicus. Skin and subcutaneous tissue overlie the defect. Evidence: TAS. Frequency: Occasional (HP:0040283). (ORPHA:231144)
- Decreased fetal movement (HP:0001558): An abnormal reduction in quantity or strength of fetal movements. Evidence: TAS. Frequency: Occasional (HP:0040283). (ORPHA:231144)
- Relative macrocephaly (HP:0004482): A relatively mild degree of macrocephaly in which the head circumference is not above two standard deviations from the mean, but appears dysproportionately large when other factors such as body stature are taken into account. Evidence: TAS. Frequency: Occasional (HP:0040283). (ORPHA:231144)
- Severe intrauterine growth retardation (HP:0008846): Intrauterine growth retardation that is 4 or more standard deviations below average, corrected for sex and gestational age. Evidence: TAS. Frequency: Occasional (HP:0040283). (ORPHA:231144)
- Floppy infant (HP:0008947): Floppiness/hypotonia is defined as reduced resistance to passive movement of joints. Physical examination of floppy/hypotonic infants shows head lag, lack of shoulder and elbow muscle contraction on traction response, inability to tighten the shoulder girdle muscles (or slipping through) when held under the axillae, scarf sign (when the arm is pulled to the opposite side, the arm wraps around the neck with the elbow crossing midline), hyperdorsiflexion of the feet, easy apposition of the thumb against the forearm, feet touching the cheek with ease and without discomfort, frog leg position, and inverted U sign on ventral suspension (head, arms, and legs hanging down without elbow or knee flexion and the trunk rounded in a dome shape). Evidence: TAS. Frequency: Occasional (HP:0040283). (ORPHA:231144)
- Prominent forehead (HP:0011220): Forward prominence of the entire forehead, due to protrusion of the frontal bone. Evidence: TAS. Frequency: Occasional (HP:0040283). (ORPHA:231144)
- Midface retrusion (HP:0011800): Posterior positions and/or vertical shortening of the infraorbital and perialar regions, or increased concavity of the face and/or reduced nasolabial angle. Evidence: TAS. Frequency: Occasional (HP:0040283). (ORPHA:231144)
These phenotypes are associated with the disease Silver-Russell syndrome due to 11p15 microduplication (ORPHA:231144).